Phenotypes associated with the disease Paramolar tubercle of bolk (OMIM:168200):
- Abnormality of the dentition (HP:0000164): Any abnormality of the teeth. Evidence: IEA. (OMIM:168200)
- Autosomal dominant inheritance (HP:0000006): A mode of inheritance that is observed for traits related to a gene encoded on one of the autosomes (i.e., the human chromosomes 1-22) in which a trait manifests in heterozygotes. In the context of medical genetics, an autosomal dominant disorder is caused when a single copy of the mutant allele is present. Males and females are affected equally, and can both transmit the disorder with a risk of 50% for each child of inheriting the mutant allele. Evidence: IEA. (OMIM:168200)